- Edema (HP:0000969): An abnormal accumulation of fluid beneath the skin, or in one or more cavities of the body. Evidence: IEA. (OMIM:615785)
- Epidermal acanthosis (HP:0025092): Diffuse hypertrophy or thickening of the stratum spinosum of the epidermis (prickle cell layer of the skin). Evidence: TAS. (OMIM:615785)
- Autosomal dominant inheritance (HP:0000006): A mode of inheritance that is observed for traits related to a gene encoded on one of the autosomes (i.e., the human chromosomes 1-22) in which a trait manifests in heterozygotes. In the context of medical genetics, an autosomal dominant disorder is caused when a single copy of the mutant allele is present. Males and females are affected equally, and can both transmit the disorder with a risk of 50% for each child of inheriting the mutant allele. Evidence: TAS. (OMIM:615785)
- Hyperparakeratosis (HP:0040009): Histological term to illustrate the combined presence of parakeratosis and hyperkeratosis. Abnormal keratinization of the epidermal stratum corneum (horny layer) with increased keratin formation and preservation of the nuclei in the superficial cells. Evidence: TAS. (OMIM:615785)
These phenotypes are associated with the disease white sponge nevus 2 (OMIM:615785).